- Dysmetria (HP:0001310): A type of ataxia characterized by the inability to carry out movements with the correct range and motion across the plane of more than one joint related to incorrect estimation of the distances required for targeted movements. Evidence: TAS. Frequency: Frequent (HP:0040282). (ORPHA:208999)
- Diminished deep tendon reflex (HP:0001315): A reduction (hyporeflexia) or complete absence (areflexia) of the involuntary muscle contraction normally elicited by a reflex stimulus, such as tapping a deep tendon. Evidence: TAS. Frequency: Frequent (HP:0040282). (ORPHA:208999)
- Gait ataxia (HP:0002066): A type of ataxia characterized by the impairment of the ability to coordinate the movements required for normal walking. Gait ataxia is characteirzed by a wide-based staggering gait with a tendency to fall. Evidence: TAS. Frequency: Frequent (HP:0040282). (ORPHA:208999)
- Dysdiadochokinesis (HP:0002075): A type of ataxia characterized by the impairment of the ability to perform rapidly alternating movements, such as pronating and supinating his or her hand on the dorsum of the other hand as rapidly as possible. Evidence: TAS. Frequency: Frequent (HP:0040282). (ORPHA:208999)
- Incoordination (HP:0002311): A deficit in coordination of muscle movements. Coordination is defined as the orchestrated movement of multiple body parts as required to accomplish intended actions, like walking. Evidence: TAS. Frequency: Frequent (HP:0040282). (ORPHA:208999)
- Positive Romberg sign (HP:0002403): The patient stands with the feet placed together and balance and is asked to close his or her eyes. A loss of balance upon eye closure is a positive Romberg sign and is interpreted as indicating a deficit in proprioception. Evidence: TAS. Frequency: Frequent (HP:0040282). (ORPHA:208999)
- Impaired distal vibration sensation (HP:0006886): A decrease in the ability to perceive vibration in the distal portions of the limbs. Evidence: TAS. Frequency: Frequent (HP:0040282). (ORPHA:208999)
- Impaired temperature sensation (HP:0010829): A reduced ability to discriminate between different temperatures. Evidence: TAS. Frequency: Frequent (HP:0040282). (ORPHA:208999)
- Sensory ataxia (HP:0010871): Incoordination of movement caused by a deficit in the sensory nervous system. Sensory ataxia can be distinguished from cerebellar ataxia by asking the patient to close his or her eyes. Persons with cerebellar ataxia show only a minimal worsening of symptoms, whereas persons with sensory ataxia show a marked worsening of symptoms. Evidence: TAS. Frequency: Frequent (HP:0040282). (ORPHA:208999)
- Dysesthesia (HP:0012534): Painful sensations elicited by a nonpainful cutaneous stimulus such as a light touch or gentle stroking over affected areas of the body. Sometimes referred to as hyperpathia or hyperalgesia. Often perceived as an intense burning, dyesthesias may outlast the stimulus by several seconds. Evidence: TAS. Frequency: Frequent (HP:0040282). (ORPHA:208999)
- Erythromelalgia (HP:0032147): Recurrent episodes of redness, burning pain, and warmth of the extremities following exposure to heat or exercise with symptoms predominantly involving the feet. Evidence: TAS. Frequency: Frequent (HP:0040282). (ORPHA:208999)
- Hand paresthesia (HP:0033660): Tingling (often referred to as a pins and needles feeling) and numbness in the hand. Evidence: TAS. Frequency: Frequent (HP:0040282). (ORPHA:208999)
- Hypoesthesia (HP:0033748): Decreased ability to perceive touch. Evidence: TAS. Frequency: Frequent (HP:0040282). (ORPHA:208999)
- Hand pain (HP:0046505): An unpleasant sensation characterized by physical discomfort localized to the hand. Evidence: TAS. Frequency: Frequent (HP:0040282). (ORPHA:208999)
- Anti-Hu antibody positivity (HP:5000016): The presence of autoantibodies (immunoglobulins) in the blood circulation that react against Hu. Evidence: TAS. Frequency: Frequent (HP:0040282). (ORPHA:208999)
- Hodgkin lymphoma (HP:0012189): A type of lymphoma characterized microscopically by multinucleated Reed-Sternberg cells. Evidence: TAS. Frequency: Occasional (HP:0040283). (ORPHA:208999)
- Small cell lung carcinoma (HP:0030357): Small cell lung cancer (SCLC) is a type of highly malignant lung cancer that is composed of small ovoid cells. In the past, SCLC was called oat cell carcinoma because the microscopic appearance of the cells was felt to resemble oats. SLCLC usually originates near the bronchi and in many cases may grow and metastasize quickly. Evidence: TAS. Frequency: Occasional (HP:0040283). (ORPHA:208999)
- Large cell lung carcinoma (HP:0030360): A type of non-small cell lung carcinoma that is derived from undifferentiated malignant neoplasms originating from transformed epithelial cells in the lung, and which is differentiate from small-cell lung carcinoma by the larger size of the anaplastic cells, a higher cytoplasmic-to-nuclear size ratio, and a lack of salt-and-pepper appearance of the chromatin. Evidence: TAS. Frequency: Occasional (HP:0040283). (ORPHA:208999)
- Follicular lymphoma (HP:0033125): An indolent B cell lymphoproliferative disorder of transformed follicular center B cells. Follicular lymphoma is characterized by diffuse lymphadenopathy, bone marrow involvement, splenomegaly and less commonly other extranodal sites of involvement. Evidence: TAS. Frequency: Occasional (HP:0040283). (ORPHA:208999)
- Neuroendocrine neoplasm (HP:0100634): A tumor that originates from a neuroendocrine cell. Evidence: TAS. Frequency: Occasional (HP:0040283). (ORPHA:208999)
These phenotypes are associated with the disease Paraneoplastic sensory ganglionopathy (ORPHA:208999).
The following phenotypes are NOT associated with this disease:
- Decreased circulating vitamin B12 concentration (HP:0100502): The concentration of vitamin B12 in the blood circulation is below the lower limit of normal. Evidence: TAS. (ORPHA:208999)
- Anti-herpes simplex antibody positivity (HP:0430058): The presence of antibodies in the blood circulation that react against a component of herpes simplex. Evidence: TAS. (ORPHA:208999)